- Nephrocalcinosis (HP:0000121): Nephrocalcinosis is the deposition of calcium salts in renal parenchyma. Evidence: IEA. (OMIM:267200)
- Rickets (HP:0002748): Rickets is divided into two major categories including calcipenic and phosphopenic. Hypophosphatemia is described as a common manifestation of both categories. Hypophosphatemic rickets is the most common type of rickets that is characterized by low levels of serum phosphate, resistance to ultraviolet radiation or vitamin D intake. There are several issues involved in hypophosphatemic rickets such as calcium, vitamin D, phosphorus deficiencies. Moreover, other disorder can be associated with its occurrence such as absorption defects due to pancreatic, intestinal, gastric, and renal disorders and hepatobiliary disease. Symptoms are usually seen in childhood and can be varied in severity. Severe forms may be linked to bowing of the legs, poor bone growth, and short stature as well as joint and bone pain. Hypophosphatemic rickets are associated with renal excretion of phosphate, hypophosphatemia, and mineral defects in bones. The familial type of the disease is the most common type of rickets. Evidence: IEA. (OMIM:267200)
- Autosomal recessive inheritance (HP:0000007): A mode of inheritance that is observed for traits related to a gene encoded on one of the autosomes (i.e., the human chromosomes 1-22) in which a trait manifests in individuals with two pathogenic alleles, either homozygotes (two copies of the same mutant allele) or compound heterozygotes (whereby each copy of a gene has a distinct mutant allele). Evidence: IEA. (OMIM:267200)
- Osteomalacia (HP:0002749): Osteomalacia is a general term for bone weakness owing to a defect in mineralization of the protein framework known as osteoid. This defective mineralization is mainly caused by lack in vitamin D. Osteomalacia in children is known as rickets. Evidence: IEA. (OMIM:267200)
- Hypokalemia (HP:0002900): The concentration of potassium(1+) in the blood circulation is below the lower limit of normal. Evidence: IEA. (OMIM:267200)
- Periodic paralysis (HP:0003768): Episodes of muscle weakness. Evidence: IEA. (OMIM:267200)
- Kidney stone (HP:0000787): Kidney stones (calculi) are mineral concretions in the renal calyces and pelvis that are found free or attached to the renal papillae. Evidence: IEA. (OMIM:267200)
- Bicarbonate-wasting renal tubular acidosis (HP:0004910). Evidence: IEA. (OMIM:267200)
These phenotypes are associated with the disease renal tubular acidosis 3 (OMIM:267200).